Phenotypes associated with the disease Fanconi-like syndrome (OMIM:227850):
- Multiple cutaneous malignancies (HP:0007606). Evidence: IEA. (OMIM:227850)
- Recurrent lower respiratory tract infections (HP:0002783): An increased susceptibility to lower respiratory tract infections as manifested by a history of recurrent lower respiratory tract infections. Evidence: IEA. (OMIM:227850)
- Multiple bilateral pneumothoraces (HP:0005939). Evidence: IEA. (OMIM:227850)
- Autosomal recessive inheritance (HP:0000007): A mode of inheritance that is observed for traits related to a gene encoded on one of the autosomes (i.e., the human chromosomes 1-22) in which a trait manifests in individuals with two pathogenic alleles, either homozygotes (two copies of the same mutant allele) or compound heterozygotes (whereby each copy of a gene has a distinct mutant allele). Evidence: IEA. (OMIM:227850)
- Pancytopenia (HP:0001876): An abnormal reduction in numbers of all blood cell types (red blood cells, white blood cells, and platelets). Evidence: IEA. (OMIM:227850)
- Osteomyelitis (HP:0002754): Osteomyelitis is an inflammatory process accompanied by bone destruction and caused by an infecting microorganism. Evidence: IEA. (OMIM:227850)